Phenotypes associated with the disease Primary condylar hyperplasia (ORPHA:477781):
- Abnormal mandible condylar process morphology (HP:3000077): An abnormality of a mandible condylar process. Evidence: TAS. Frequency: Very frequent (HP:0040281). (ORPHA:477781)
- Abnormality of the chin (HP:0000306): An abnormality of the chin, i.e., of the inferior portion of the face lying inferior to the lower lip and including the central prominence of the lower jaw. Evidence: TAS. Frequency: Frequent (HP:0040282). (ORPHA:477781)
- Facial asymmetry (HP:0000324): An abnormal difference between the left and right sides of the face. Evidence: TAS. Frequency: Frequent (HP:0040282). (ORPHA:477781)
- Anterior open-bite malocclusion (HP:0009102): Anterior open bite is a malocclusion characterized by a gap between the anterior teeth (incisors), that is, by a deficiency in the normal vertical overlap between antagonist incisal edges when the posterior teeth are in occlusion. Evidence: TAS. Frequency: Frequent (HP:0040282). (ORPHA:477781)
- Abnormality of the temporomandibular joint (HP:0010754): An anomaly of the temporomandibular joint. Evidence: TAS. Frequency: Frequent (HP:0040282). (ORPHA:477781)
- Macrodontia (HP:0001572): Increased size of the teeth, which can be defined as a mesiodistal tooth diameter (width) more than 2 SD above mean for age. Alternatively, an apparently increased maximum width of the tooth. Evidence: TAS. Frequency: Occasional (HP:0040283). (ORPHA:477781)